Phenotypes associated with the disease Mietens syndrome (OMIM:249600):
- Strabismus (HP:0000486): A misalignment of the eyes so that the visual axes deviate from bifoveal fixation. The classification of strabismus may be based on a number of features including the relative position of the eyes, whether the deviation is latent or manifest, intermittent or constant, concomitant or otherwise and according to the age of onset and the relevance of any associated refractive error. Evidence: IEA. (OMIM:249600)
- Mild intellectual disability (HP:0001256): Mild intellectual disability (ID) is defined as a type of ID characterized by mildly sub-average adaptive functioning and intellectual functioning, with an intelligence quotient (IQ) the range of 50-69. Evidence: IEA. Frequency: Occasional (HP:0040283). (OMIM:249600)
- Nystagmus (HP:0000639): Rhythmic, involuntary oscillations of one or both eyes related to abnormality in fixation, conjugate gaze, or vestibular mechanisms. Evidence: IEA. (OMIM:249600)
- Narrow nose (HP:0000460): Interalar distance more than 2 SD below the mean for age, or alternatively, an apparently decreased width of the nasal base and alae. Evidence: TAS. (OMIM:249600)
- Autosomal recessive inheritance (HP:0000007): A mode of inheritance that is observed for traits related to a gene encoded on one of the autosomes (i.e., the human chromosomes 1-22) in which a trait manifests in individuals with two pathogenic alleles, either homozygotes (two copies of the same mutant allele) or compound heterozygotes (whereby each copy of a gene has a distinct mutant allele). Evidence: IEA. (OMIM:249600)
- Severe postnatal growth retardation (HP:0008850): Severely slow or limited growth after birth, being four standard deviations or more below age- and sex-related norms. Evidence: IEA. (OMIM:249600)
- Forearm undergrowth (HP:0009821): Forearm shortening because of underdevelopment of one or more bones of the forearm. Evidence: IEA. (OMIM:249600)
- Dislocated radial head (HP:0003083): A dislocation of the head of the radius from its socket in the elbow joint. Evidence: IEA. (OMIM:249600)
- Pes planus (HP:0001763): A foot where the longitudinal arch of the foot is in contact with the ground or floor when the individual is standing; or, in a patient lying supine, a foot where the arch is in contact with the surface of a flat board pressed against the sole of the foot by the examiner with a pressure similar to that expected from weight bearing; or, the height of the arch is reduced. Evidence: IEA. (OMIM:249600)
- Elbow flexion contracture (HP:0002987): An elbow contracture that limits the ability of the elbow joint to be extended (straightened), meaning that the elbow is fixed in an flexed (bent) position. Evidence: IEA. (OMIM:249600)
- Absent proximal radial epiphyses (HP:0005093): Absence of the proximal radial epiphysis. Evidence: IEA. (OMIM:249600)
- Intellectual disability (HP:0001249): The term intellectual disability or intellectual developmental disorder is used to describe significantly sub-average intellectual and adaptive functioning based on clinical assessment and as measured by individually administered, appropriately normed, standardized and validated tests of intellectual functioning and adaptive behavior, with onset during the developmental period from infancy through adolescence. Evidence: TAS. (OMIM:249600)